Phenotypes associated with the disease Gerstmann-Straussler-Scheinker syndrome (ORPHA:356):
- Gait ataxia (HP:0002066): A type of ataxia characterized by the impairment of the ability to coordinate the movements required for normal walking. Gait ataxia is characteirzed by a wide-based staggering gait with a tendency to fall. Evidence: TAS. Frequency: Very frequent (HP:0040281). (ORPHA:356)
- Lower limb muscle weakness (HP:0007340): Weakness of the muscles of the legs. Evidence: TAS. Frequency: Very frequent (HP:0040281). (ORPHA:356)
- Dysesthesia (HP:0012534): Painful sensations elicited by a nonpainful cutaneous stimulus such as a light touch or gentle stroking over affected areas of the body. Sometimes referred to as hyperpathia or hyperalgesia. Often perceived as an intense burning, dyesthesias may outlast the stimulus by several seconds. Evidence: TAS. Frequency: Very frequent (HP:0040281). (ORPHA:356)
- Cognitive impairment (HP:0100543): Abnormal cognition is characterized by deficits in thinking, reasoning, or remembering. Evidence: TAS. Frequency: Very frequent (HP:0040281). (ORPHA:356)
- Dementia (HP:0000726): A loss of global cognitive ability of sufficient amount to interfere with normal social or occupational function. Dementia represents a loss of previously present cognitive abilities, generally in adults, and can affect memory, thinking, language, judgment, and behavior. Evidence: TAS. Frequency: Frequent (HP:0040282). (ORPHA:356)
- Dysarthria (HP:0001260): Dysarthric speech is a general description referring to a neurological speech disorder characterized by poor articulation. Depending on the involved neurological structures, dysarthria may be further classified as spastic, flaccid, ataxic, hyperkinetic and hypokinetic, or mixed. Evidence: TAS. Frequency: Frequent (HP:0040282). (ORPHA:356)
- Mental deterioration (HP:0001268): Loss of previously present mental abilities, generally in adults. Evidence: TAS. Frequency: Frequent (HP:0040282). (ORPHA:356)
- Areflexia (HP:0001284): Absence of neurologic reflexes such as the knee-jerk reaction. Evidence: TAS. Frequency: Frequent (HP:0040282). (ORPHA:356)
- Diminished deep tendon reflex (HP:0001315): A reduction (hyporeflexia) or complete absence (areflexia) of the involuntary muscle contraction normally elicited by a reflex stimulus, such as tapping a deep tendon. Evidence: TAS. Frequency: Frequent (HP:0040282). (ORPHA:356)
- Abnormal cerebellum morphology (HP:0001317): Any structural abnormality of the cerebellum. Evidence: TAS. Frequency: Frequent (HP:0040282). (ORPHA:356)
- Abnormal pyramidal tract morphology (HP:0002062): Any structural abnormality of the pyramidal tract, whose chief element, the corticospinal tract, is the only direct connection between the brain and the spinal cord. In addition to the corticospinal tract, the pyramidal system includes the corticobulbar, corticomesencephalic, and corticopontine tracts. Evidence: TAS. Frequency: Frequent (HP:0040282). (ORPHA:356)
- Abnormality of extrapyramidal motor function (HP:0002071): A neurological condition related to lesions of the basal ganglia leading to typical abnormalities including akinesia (inability to initiate changes in activity and perform volitional movements rapidly and easily), muscular rigidity (continuous contraction of muscles with constant resistance to passive movement), chorea (widespread arrhythmic movements of a forcible, rapid, jerky, and restless nature), athetosis (inability to sustain the muscles of the fingers, toes, or other group of muscles in a fixed position), and akathisia (inability to remain motionless). Evidence: TAS. Frequency: Frequent (HP:0040282). (ORPHA:356)
- Sleep disturbance (HP:0002360): An abnormal pattern in the quality, quantity, or characteristics of sleep. Evidence: TAS. Frequency: Frequent (HP:0040282). (ORPHA:356)
- Paresthesia (HP:0003401): Abnormal sensations such as tingling, pricking, or numbness of the skin with no apparent physical cause. Evidence: TAS. Frequency: Frequent (HP:0040282). (ORPHA:356)
- Abnormal central sensory function (HP:0011730): An abnormality of sensation related to CNS function. Assuming the primary sensory modalities are intact and the patient is alert and cooperative, the presence of an abnormality of sensory function may indicate a lesion of a parietal cortex, the thalamocortical projections to the parietal cortex, or the spinal cord. Evidence: TAS. Frequency: Frequent (HP:0040282). (ORPHA:356)
- Acroparesthesia (HP:0031006): A type of paresthesia (tingling, pins-and-needles, burning or numbness or stiffness) that occurs in the hands and feet and particularly in the fingers and toes. Evidence: TAS. Frequency: Frequent (HP:0040282). (ORPHA:356)
- Brain imaging abnormality (HP:0410263): An anomaly of metabolism or structure of the brain identified by imaging. Evidence: TAS. Frequency: Frequent (HP:0040282). (ORPHA:356)
- Limb myoclonus (HP:0045084). Evidence: TAS. Frequency: Occasional (HP:0040283). (ORPHA:356)